Phenotypes associated with the disease SHORT SLEEPER (OMIM:612975):
- Shortened sleep phase (HP:0033063): A tendency to sleep fewer hours than usual while feeling well-rested. Evidence: PCS. (PMID:19679812)
- Autosomal dominant inheritance (HP:0000006): A mode of inheritance that is observed for traits related to a gene encoded on one of the autosomes (i.e., the human chromosomes 1-22) in which a trait manifests in heterozygotes. In the context of medical genetics, an autosomal dominant disorder is caused when a single copy of the mutant allele is present. Males and females are affected equally, and can both transmit the disorder with a risk of 50% for each child of inheriting the mutant allele. Evidence: PCS. (PMID:19679812)